- Resting tremor (HP:0002322): A resting tremor occurs when muscles are at rest and becomes less noticeable or disappears when the affected muscles are moved. Resting tremors are often slow and coarse. Evidence: PCS. Frequency: 10/12. (PMID:12244316)
- Bradykinesia (HP:0002067): Bradykinesia literally means slow movement, and is used clinically to denote a slowness in the execution of movement (in contrast to hypokinesia, which is used to refer to slowness in the initiation of movement). Evidence: PCS. Frequency: 10/12. (PMID:12244316)
- Orthostatic hypotension (HP:0001278): A form of hypotension characterized by a sudden fall in blood pressure that occurs when a person assumes a standing position. Evidence: PCS. Frequency: 2/12. (PMID:12244316)
- Middle age onset (HP:0003596): A type of adult onset with onset of symptoms at the age of 40 to 60 years. Evidence: PCS. Frequency: 5/12. (PMID:12244316)
- Gait disturbance (HP:0001288): The term gait disturbance can refer to any disruption of the ability to walk. Evidence: PCS. Frequency: 12/12. (PMID:12244316)
- Late onset (HP:0003584): A type of adult onset with onset of symptoms after the age of 60 years. Evidence: PCS. Frequency: 7/12. (PMID:12244316)
- Rigidity (HP:0002063): Continuous involuntary sustained muscle contraction. When an affected muscle is passively stretched, the degree of resistance remains constant regardless of the rate at which the muscle is stretched. This feature helps to distinguish rigidity from muscle spasticity. Evidence: PCS. Frequency: 10/12. (PMID:12244316)
- Postural instability (HP:0002172): A tendency to fall or the inability to keep oneself from falling; imbalance. The retropulsion test is widely regarded as the gold standard to evaluate postural instability, Use of the retropulsion test includes a rapid balance perturbation in the backward direction, and the number of balance correcting steps (or total absence thereof) is used to rate the degree of postural instability. Healthy subjects correct such perturbations with either one or two large steps, or without taking any steps, hinging rapidly at the hips while swinging the arms forward as a counterweight. In patients with balance impairment, balance correcting steps are often too small, forcing patients to take more than two steps. Taking three or more steps is generally considered to be abnormal, and taking more than five steps is regarded as being clearly abnormal. Markedly affected patients continue to step backward without ever regaining their balance and must be caught by the examiner (this would be called true retropulsion). Even more severely affected patients fail to correct entirely, and fall backward like a pushed toy soldier, without taking any corrective steps. Evidence: PCS. Frequency: 6/12. (PMID:12244316)
- Restless legs (HP:0012452): An irresistible urge to move the legs, usually accompanied by unpleasant sensations deep within the limbs. Symptoms typically begin or worsen during periods of rest or inactivity, are most pronounced in the evening or at night, and are temporarily relieved by movement such as walking or stretching. The disturbance often interferes with the initiation or maintenance of sleep. Evidence: PCS. Frequency: 0/12. (PMID:12244316)
- Depression (HP:0000716): Frequently experiencing feelings of being down, miserable, and/or hopeless; struggling to recover from these moods; having a pessimistic outlook on the future; feeling a pervasive sense of shame; having a low self-worth; experiencing thoughts of suicide and engaging in suicidal behavior. Evidence: PCS. Frequency: 1/12. (PMID:12244316)
- Hallucinations (HP:0000738): Perceptions in a conscious and awake state that, in the absence of external stimuli, have qualities of real perception. These perceptions are vivid, substantial, and located in external objective space. Evidence: PCS. Frequency: 0/12. (PMID:12244316)
- Dementia (HP:0000726): A loss of global cognitive ability of sufficient amount to interfere with normal social or occupational function. Dementia represents a loss of previously present cognitive abilities, generally in adults, and can affect memory, thinking, language, judgment, and behavior. Evidence: PCS. Frequency: 0/12. (PMID:12244316)
- Parkinsonism with favorable response to dopaminergic medication (HP:0002548): Parkinsonism is a clinical syndrome that is a feature of a number of different diseases, including Parkinson disease itself, other neurodegenerative diseases such as progressive supranuclear palsy, and as a side-effect of some neuroleptic medications. Some but not all individuals with Parkinsonism show responsiveness to dopaminergic medication defined as a substantial reduction of amelioration of the component signs of Parkinsonism (including mainly tremor, bradykinesia, rigidity, and postural instability) upon administration of dopaminergic medication. Evidence: PCS. Frequency: 8/12. (PMID:12244316)
- Constipation (HP:0002019): Infrequent or difficult evacuation of feces. Evidence: PCS. Frequency: 6/12. (PMID:12244316)
- Autosomal dominant inheritance (HP:0000006): A mode of inheritance that is observed for traits related to a gene encoded on one of the autosomes (i.e., the human chromosomes 1-22) in which a trait manifests in heterozygotes. In the context of medical genetics, an autosomal dominant disorder is caused when a single copy of the mutant allele is present. Males and females are affected equally, and can both transmit the disorder with a risk of 50% for each child of inheriting the mutant allele. Evidence: PCS. (PMID:12244316)
- Hyperreflexia (HP:0001347): Hyperreflexia is the presence of hyperactive stretch reflexes of the muscles. Evidence: PCS. Frequency: 4/12. (PMID:12244316)
These phenotypes are associated with the disease Parkinson disease 22, autosomal dominant (OMIM:616710).